- Male infertility (HP:0003251). Evidence: PCS. Frequency: 3/3. (PMID:23582645)
- Young adult onset (HP:0011462): Onset of disease at the age of between 16 and 40 years. Evidence: PCS. Frequency: 3/3. (PMID:23582645)
- Reduced sperm motility (HP:0012207): An abnormal reduction in the mobility of ejaculated sperm. Evidence: PCS. Frequency: 3/3. (PMID:23582645)
- Autosomal dominant inheritance (HP:0000006): A mode of inheritance that is observed for traits related to a gene encoded on one of the autosomes (i.e., the human chromosomes 1-22) in which a trait manifests in heterozygotes. In the context of medical genetics, an autosomal dominant disorder is caused when a single copy of the mutant allele is present. Males and females are affected equally, and can both transmit the disorder with a risk of 50% for each child of inheriting the mutant allele. Evidence: PCS. (PMID:23582645)
These phenotypes are associated with the disease spermatogenic failure 3 (OMIM:606766).